Phenotypes associated with the disease Intellectual disability, Wolff type (ORPHA:3080):
- Inguinal hernia (HP:0000023): Protrusion of the contents of the abdominal cavity through the inguinal canal. Evidence: TAS. Frequency: Frequent (HP:0040282). (ORPHA:3080)
- Cryptorchidism (HP:0000028): Testis in inguinal canal. That is, absence of one or both testes from the scrotum owing to failure of the testis or testes to descend through the inguinal canal to the scrotum. Evidence: TAS. Frequency: Frequent (HP:0040282). (ORPHA:3080)
- Hypospadias (HP:0000047): Abnormal position of urethral meatus on the ventral penile shaft (underside) characterized by displacement of the urethral meatus from the tip of the glans penis to the ventral surface of the penis, scrotum, or perineum. Evidence: TAS. Frequency: Very frequent (HP:0040281). (ORPHA:3080)
- Thick lower lip vermilion (HP:0000179): Increased thickness of the lower lip, leading to a prominent appearance of the lower lip. The height of the vermilion of the lower lip in the midline is more than 2 SD above the mean. Alternatively, an apparently increased height of the vermilion of the lower lip in the frontal view (subjective). Evidence: TAS. Frequency: Very frequent (HP:0040281). (ORPHA:3080)
- Orofacial cleft (HP:0000202): The presence of a cleft (gap, opening, or groove) in the oral cavity, including cleft of the upper lip and/or cleft of the palate. Cleft of the upper lip is visible as a groove or fissure in the lip, most frequently due to a congenital failure of the maxillary and median nasal processes to fuse. Cleft palate is characterized by a grooved depression or fissure in the roof of the mouth, most often resulting from a congenital failure of the palate to fuse properly. Clefts of the lip and palate can occur individually or together. It is preferable to code each defect separately. Evidence: TAS. Frequency: Frequent (HP:0040282). (ORPHA:3080)
- Microretrognathia (HP:0000308): A form of developmental hypoplasia of the mandible in which the mandible is mislocalised posteriorly. Evidence: TAS. Frequency: Very frequent (HP:0040281). (ORPHA:3080)
- Hypertelorism (HP:0000316): Interpupillary distance more than 2 SD above the mean (alternatively, the appearance of an increased interpupillary distance or widely spaced eyes). Evidence: TAS. Frequency: Very frequent (HP:0040281). (ORPHA:3080)
- Sloping forehead (HP:0000340): Inclination of the anterior surface of the forehead from the vertical more than two standard deviations above the mean (objective); or apparently excessive posterior sloping of the forehead in a lateral view. Evidence: TAS. Frequency: Frequent (HP:0040282). (ORPHA:3080)
- Macrotia (HP:0000400): Median longitudinal ear length greater than two standard deviations above the mean and median ear width greater than two standard deviations above the mean (objective); or, apparent increase in length and width of the pinna (subjective). Evidence: TAS. Frequency: Very frequent (HP:0040281). (ORPHA:3080)
- Bulbous nose (HP:0000414): Increased volume and globular shape of the anteroinferior aspect of the nose. Evidence: TAS. Frequency: Very frequent (HP:0040281). (ORPHA:3080)
- Wide nasal bridge (HP:0000431): Increased breadth of the nasal bridge (and with it, the nasal root). Evidence: TAS. Frequency: Very frequent (HP:0040281). (ORPHA:3080)
- Strabismus (HP:0000486): A misalignment of the eyes so that the visual axes deviate from bifoveal fixation. The classification of strabismus may be based on a number of features including the relative position of the eyes, whether the deviation is latent or manifest, intermittent or constant, concomitant or otherwise and according to the age of onset and the relevance of any associated refractive error. Evidence: TAS. Frequency: Frequent (HP:0040282). (ORPHA:3080)
- Upslanted palpebral fissure (HP:0000582): The palpebral fissure inclination is more than two standard deviations above the mean for age (objective); or, the inclination of the palpebral fissure is greater than typical for age. Evidence: TAS. Frequency: Very frequent (HP:0040281). (ORPHA:3080)
- Large hands (HP:0001176). Evidence: TAS. Frequency: Very frequent (HP:0040281). (ORPHA:3080)
- Seizure (HP:0001250): A seizure is an intermittent abnormality of nervous system physiology characterized by a transient occurrence of signs and/or symptoms due to abnormal excessive or synchronous neuronal activity in the brain. Evidence: TAS. Frequency: Frequent (HP:0040282). (ORPHA:3080)
- Limitation of joint mobility (HP:0001376): A reduction in the freedom of movement of one or more joints. Evidence: TAS. Frequency: Very frequent (HP:0040281). (ORPHA:3080)
- Abnormal nail morphology (HP:0001597): Abnormal structure or appearance of the nail. Evidence: TAS. Frequency: Frequent (HP:0040282). (ORPHA:3080)
- Low posterior hairline (HP:0002162): Hair on the neck extends more inferiorly than usual. Evidence: TAS. Frequency: Very frequent (HP:0040281). (ORPHA:3080)
- Abnormal intestine morphology (HP:0002242): An abnormality of the intestine. The closely related term enteropathy is used to refer to any disease of the intestine. Evidence: TAS. Frequency: Frequent (HP:0040282). (ORPHA:3080)
- Scoliosis (HP:0002650): The presence of an abnormal lateral curvature of the spine. Evidence: TAS. Frequency: Frequent (HP:0040282). (ORPHA:3080)
- Delayed skeletal maturation (HP:0002750): A decreased rate of skeletal maturation. Delayed skeletal maturation can be diagnosed on the basis of an estimation of the bone age from radiographs of specific bones in the human body. Evidence: TAS. Frequency: Very frequent (HP:0040281). (ORPHA:3080)
- Clinodactyly of the 5th finger (HP:0004209): Clinodactyly refers to a bending or curvature of the fifth finger in the radial direction (i.e., towards the 4th finger). Evidence: TAS. Frequency: Frequent (HP:0040282). (ORPHA:3080)
- Hypoplastic superior helix (HP:0008559). Evidence: TAS. Frequency: Frequent (HP:0040282). (ORPHA:3080)
- Short distal phalanx of finger (HP:0009882): Short distance from the end of the finger to the most distal interphalangeal crease or the distal interphalangeal joint flexion point. That is, hypoplasia of one or more of the distal phalanx of finger. Evidence: TAS. Frequency: Very frequent (HP:0040281). (ORPHA:3080)
- Severe intellectual disability (HP:0010864): Severe intellectual disability (ID) is defined as a type of ID characterized by severely sub-average adaptive functioning and intellectual functioning, with an intelligence quotient (IQ) the range of 20-34. Evidence: TAS. Frequency: Very frequent (HP:0040281). (ORPHA:3080)
- Broad thumb (HP:0011304): Increased thumb width without increased dorso-ventral dimension. Evidence: TAS. Frequency: Frequent (HP:0040282). (ORPHA:3080)
- Severe global developmental delay (HP:0011344): A severe delay in the achievement of motor or mental milestones in the domains of development of a child. Evidence: TAS. Frequency: Very frequent (HP:0040281). (ORPHA:3080)
- Non-midline cleft of the upper lip (HP:0100335): Clefting (gap or groove) of the upper lip affecting the lateral portions of the upper lip rather than the midline/median region. Evidence: TAS. Frequency: Frequent (HP:0040282). (ORPHA:3080)
- Camptodactyly of finger (HP:0100490): The distal interphalangeal joint and/or the proximal interphalangeal joint of the fingers cannot be extended to 180 degrees by either active or passive extension. Evidence: TAS. Frequency: Very frequent (HP:0040281). (ORPHA:3080)